Phenotypes associated with the disease autosomal dominant nonsyndromic hearing loss 12 (OMIM:601543):
- Sensorineural hearing impairment (HP:0000407): A type of hearing impairment in one or both ears related to an abnormal functionality of the cochlear nerve. Evidence: TAS. (OMIM:601543)
- Autosomal dominant inheritance (HP:0000006): A mode of inheritance that is observed for traits related to a gene encoded on one of the autosomes (i.e., the human chromosomes 1-22) in which a trait manifests in heterozygotes. In the context of medical genetics, an autosomal dominant disorder is caused when a single copy of the mutant allele is present. Males and females are affected equally, and can both transmit the disorder with a risk of 50% for each child of inheriting the mutant allele. Evidence: IEA. (OMIM:601543)